Phenotypes associated with the disease Apnea of prematurity (ORPHA:99981):
- Apnea (HP:0002104): Lack of breathing with no movement of the respiratory muscles and no exchange of air in the lungs. This term refers to a disposition to have recurrent episodes of apnea rather than to a single event. Evidence: TAS. Frequency: Very frequent (HP:0040281). (ORPHA:99981)
- Cyanosis (HP:0000961): Bluish discoloration of the skin and mucosa due to poor circulation or inadequate oxygenation of arterial or capillary blood. Evidence: TAS. Frequency: Frequent (HP:0040282). (ORPHA:99981)
- Bradycardia (HP:0001662): A slower than normal heart rate (in adults, slower than 60 beats per minute). Evidence: TAS. Frequency: Frequent (HP:0040282). (ORPHA:99981)
- Hypoxemia (HP:0012418): An abnormally low level of blood oxygen. Evidence: TAS. Frequency: Frequent (HP:0040282). (ORPHA:99981)
- Failure to thrive in infancy (HP:0001531). Evidence: TAS. Frequency: Occasional (HP:0040283). (ORPHA:99981)